- Bifid uvula (HP:0000193): Uvula separated into two parts most easily seen at the tip. Evidence: TAS. Frequency: Obligate (HP:0040280). (ORPHA:99771)
- Nasal dysarthria (HP:0008376). Evidence: TAS. Frequency: Frequent (HP:0040282). (ORPHA:99771)
- Submucous cleft soft palate (HP:0011819): A cleft of the muscular (soft) portion of the palate that is covered by mucous membrane. Soft-palate submucous clefts are characterized by a midline deficiency or lack of muscle tissue. Evidence: TAS. Frequency: Occasional (HP:0040283). (ORPHA:99771)
- Cleft lip (HP:0410030): A gap in the lip or lips. Evidence: TAS. Frequency: Occasional (HP:0040283). (ORPHA:99771)
These phenotypes are associated with the disease Bifid uvula (ORPHA:99771).